Phenotypes associated with the disease PCDH19 clustering epilepsy (ORPHA:714652):
- Febrile seizure (within the age range of 3 months to 6 years) (HP:0002373): A febrile seizure is any type of seizure (most often a generalized tonic-clonic seizure) occurring with fever (at least 38 degrees Celsius) but in the absence of central nervous system infection, severe metabolic disturbance or other alternative precipitant in children between the ages of 3 months and 6 years. Evidence: TAS. Frequency: Very frequent (HP:0040281). (ORPHA:714652)
- Atypical behavior (HP:0000708): Atypical behavior is an abnormality in a person's actions that can be controlled or modulated by the will of the individual. While abnormal behaviors can be difficult to control, they are distinct from other abnormal actions that cannot be affected by the individual's will. Evidence: TAS. Frequency: Frequent (HP:0040282). (ORPHA:714652)
- Aggressive behavior (HP:0000718): Behavior or an act aimed at harming a person, animal, or physical property (e.g., acts of physical violence; shouting, swearing, and using harsh language; slashing someone's tires). Evidence: TAS. Frequency: Frequent (HP:0040282). (ORPHA:714652)
- Compulsive behaviors (HP:0000722): Behavior that consists of repetitive acts, characterized by the feeling that one "has to" perform them, while being aware that these acts are not in line with one's overall goal. Evidence: TAS. Frequency: Frequent (HP:0040282). (ORPHA:714652)
- Anxiety (HP:0000739): Intense feelings of nervousness, tension, or panic often arise in response to interpersonal stresses. There is worry about the negative effects of past unpleasant experiences and future negative possibilities. Individuals may feel fearful, apprehensive, or threatened by uncertainty, and they may also have fears of falling apart or losing control. Evidence: TAS. Frequency: Frequent (HP:0040282). (ORPHA:714652)
- Delayed speech and language development (HP:0000750): A degree of language development that is significantly below the norm for a child of a specified age. Evidence: TAS. Frequency: Frequent (HP:0040282). (ORPHA:714652)
- Intellectual disability (HP:0001249): The term intellectual disability or intellectual developmental disorder is used to describe significantly sub-average intellectual and adaptive functioning based on clinical assessment and as measured by individually administered, appropriately normed, standardized and validated tests of intellectual functioning and adaptive behavior, with onset during the developmental period from infancy through adolescence. Evidence: TAS. Frequency: Frequent (HP:0040282). (ORPHA:714652)
- Motor delay (HP:0001270): A type of Developmental delay characterized by a delay in acquiring motor skills. Evidence: TAS. Frequency: Frequent (HP:0040282). (ORPHA:714652)
- Bilateral tonic-clonic seizure (HP:0002069): A bilateral tonic-clonic seizure is a seizure defined by a tonic (bilateral increased tone, lasting seconds to minutes) and then a clonic (bilateral sustained rhythmic jerking) phase. Evidence: TAS. Frequency: Frequent (HP:0040282). (ORPHA:714652)
- Status epilepticus (HP:0002133): Status epilepticus is a type of prolonged seizure resulting either from the failure of the mechanisms responsible for seizure termination or from the initiation of mechanisms which lead to abnormally prolonged seizures (after time point t1). It is a condition that can have long-term consequences (after time point t2), including neuronal death, neuronal injury, and alteration of neuronal networks, depending on the type and duration of seizures. Evidence: TAS. Frequency: Frequent (HP:0040282). (ORPHA:714652)
- Generalized tonic seizure (HP:0010818): A generalized tonic seizure is a type of generalized motor seizure characterized by bilateral limb stiffening or elevation, often with neck stiffening without a subsequent clonic phase. The tonic activity can be a sustained abnormal posture, either in extension or flexion, sometimes accompanied by tremor of the extremities. Evidence: TAS. Frequency: Frequent (HP:0040282). (ORPHA:714652)
- Generalized clonic seizure (HP:0011169): Generalized clonic seizure is a type of generalized motor seizure characterized by sustained bilateral jerking, either symmetric or asymmetric, that is regularly repetitive and involves the same muscle groups. Evidence: TAS. Frequency: Frequent (HP:0040282). (ORPHA:714652)
- Abnormal social behavior (HP:0012433): An abnormality of actions or reactions of a person exhibited during social interactions with other individuals. Evidence: TAS. Frequency: Frequent (HP:0040282). (ORPHA:714652)
- Autistic behavior (HP:0000729): Persistent deficits in social interaction and communication and interaction as well as a markedly restricted repertoire of activity and interest as well as repetitive patterns of behavior. Evidence: TAS. Frequency: Occasional (HP:0040283). (ORPHA:714652)
- Hyperactivity (HP:0000752): Hyperactivity is a condition characterized by constant and unusually high levels of activity, even in situations where it is deemed inappropriate. Evidence: TAS. Frequency: Occasional (HP:0040283). (ORPHA:714652)
- Mild intellectual disability (HP:0001256): Mild intellectual disability (ID) is defined as a type of ID characterized by mildly sub-average adaptive functioning and intellectual functioning, with an intelligence quotient (IQ) the range of 50-69. Evidence: TAS. Frequency: Occasional (HP:0040283). (ORPHA:714652)
- Global developmental delay (HP:0001263): A delay in the achievement of motor or mental milestones in the domains of development of a child, including motor skills, speech and language, cognitive skills, and social and emotional skills. This term should only be used to describe children younger than five years of age. Evidence: TAS. Frequency: Occasional (HP:0040283). (ORPHA:714652)
- Generalized non-motor (absence) seizure (HP:0002121): A generalized non-motor (absence) seizure is a type of a type of dialeptic seizure that is of electrographically generalized onset. It is a generalized seizure characterized by an interruption of activities, a blank stare, and usually the person will be unresponsive when spoken to. Any ictal motor phenomena are minor in comparison to these non-motor features. Evidence: TAS. Frequency: Occasional (HP:0040283). (ORPHA:714652)
- Generalized myoclonic seizure (HP:0002123): A generalized myoclonic seizure is a type of generalized motor seizure characterized by bilateral, sudden, brief (<100 ms) involuntary single or multiple contraction of muscles or muscle groups of variable topography (axial, proximal limb, distal). Myoclonus is less regularly repetitive and less sustained than is clonus. Evidence: TAS. Frequency: Occasional (HP:0040283). (ORPHA:714652)
- Profound intellectual disability (HP:0002187): Profound intellectual disability (ID) is defined as a type of ID characterized by profoundly sub-average adaptive functioning and intellectual functioning, with an intelligence quotient (IQ) below 20. Evidence: TAS. Frequency: Occasional (HP:0040283). (ORPHA:714652)
- Moderate intellectual disability (HP:0002342): Moderate intellectual disability (ID) is defined as a type of ID characterized by moderately sub-average adaptive functioning and intellectual functioning, with an intelligence quotient (IQ) the range of 35-49. Evidence: TAS. Frequency: Occasional (HP:0040283). (ORPHA:714652)
- Atypical absence seizure (HP:0007270): An atypical absence seizure is a type of generalized non-motor (absence) seizure characterized by interruption of ongoing activities and reduced responsiveness. In comparison to a typical absence seizure, changes in tone may be more pronounced, onset and/or cessation may be less abrupt, and the duration of the ictus and post-ictal recovery may be longer. Although not always available, an EEG often demonstrates slow (<3 Hz), irregular, generalized spike-wave activity. Evidence: TAS. Frequency: Occasional (HP:0040283). (ORPHA:714652)
- Focal-onset seizure (HP:0007359): A focal-onset seizure is a type of seizure originating within networks limited to one hemisphere. They may be discretely localized or more widely distributed, and may originate in subcortical structures. Evidence: TAS. Frequency: Occasional (HP:0040283). (ORPHA:714652)
- Atonic seizure (HP:0010819): Atonic seizure is a type of motor seizure characterized by a sudden loss or diminution of muscle tone without apparent preceding myoclonic or tonic event lasting about 1 to 2 seconds, involving head, trunk, jaw, or limb musculature. Evidence: TAS. Frequency: Occasional (HP:0040283). (ORPHA:714652)
- Severe intellectual disability (HP:0010864): Severe intellectual disability (ID) is defined as a type of ID characterized by severely sub-average adaptive functioning and intellectual functioning, with an intelligence quotient (IQ) the range of 20-34. Evidence: TAS. Frequency: Occasional (HP:0040283). (ORPHA:714652)
- Complex febrile seizure (HP:0011172): A febrile seizure that has any of the following features: focal semiology (or associated with post-ictal neurologic abnormalities beyond drowsiness, such as a Todd's paresis), prolonged seizure beyond 15 minutes, or recurring (occurring more than once) in a 24 hour period. Evidence: TAS. Frequency: Occasional (HP:0040283). (ORPHA:714652)
- Impulsivity (HP:0100710): Acting on the spur of the moment or on a momentary basis without consideration of outcomes; having difficulty establishing or following plans; experiencing a sense of urgency and engaging in behavior that is uninhibited, cannot be inhibited, and is uncontrolled. The possibility of repression is inconceivable. Evidence: TAS. Frequency: Occasional (HP:0040283). (ORPHA:714652)
- Psychosis (HP:0000709): A condition characterized by changes in personality and thought patterns, often accompanied by hallucinations and delusional beliefs, is known as psychosis. Evidence: TAS. Frequency: Very rare (HP:0040284). (ORPHA:714652)
- Abnormal eating behavior (HP:0100738): Abnormal eating habits involve excessive or insufficient consumption of food, or any other abnormal pattern of food consumption. Evidence: TAS. Frequency: Very rare (HP:0040284). (ORPHA:714652)